- Autosomal recessive inheritance (HP:0000007): A mode of inheritance that is observed for traits related to a gene encoded on one of the autosomes (i.e., the human chromosomes 1-22) in which a trait manifests in individuals with two pathogenic alleles, either homozygotes (two copies of the same mutant allele) or compound heterozygotes (whereby each copy of a gene has a distinct mutant allele). Evidence: TAS. (OMIM:611090)
- Intellectual disability (HP:0001249): The term intellectual disability or intellectual developmental disorder is used to describe significantly sub-average intellectual and adaptive functioning based on clinical assessment and as measured by individually administered, appropriately normed, standardized and validated tests of intellectual functioning and adaptive behavior, with onset during the developmental period from infancy through adolescence. Evidence: TAS. (OMIM:611090)
These phenotypes are associated with the disease intellectual disability, autosomal recessive 12 (OMIM:611090).